Phenotypes associated with the disease long QT syndrome 5 (OMIM:613695):
- Ventricular fibrillation (HP:0001663): Uncontrolled contractions of muscles fibers in the left ventricle not producing contraction of the left ventricle. Ventricular fibrillation usually begins with a ventricular premature contraction and a short run of rapid ventricular tachycardia degenerating into uncoordinating ventricular fibrillations. Evidence: PCS. Frequency: 1/2. (PMID:20823649)
- Early young adult onset (HP:0025708): Onset of disease at an age of greater than or equal to 16 to under 19 years. Evidence: PCS. Frequency: 2/2. (PMID:20823649)
- Prolonged QTc interval (HP:0005184): A longer than normal interval (corrected for heart rate) between the Q and T waves in the heart's cycle. Prolonged QTc can cause premature action potentials during late phase depolarizations thereby leading to ventricular arrhythmias and ventricular fibrillations. Evidence: PCS. Frequency: 6/7. (PMID:9354802;PMID:20823649)
- Syncope (HP:0001279): A transient loss of consciousness (i.e., characterized by a rapid onset, a short duration, and a spontaneous and complete recovery) due to cerebral hypoperfusion. Evidence: TAS. (OMIM:613695)
- Torsade de pointes (HP:0001664): A type of ventricular tachycardia characterized by polymorphioc QRS complexes that change in amplitue and cycle length, and thus have the appearance of oscillating around the baseline in the EKG. Evidence: TAS. (OMIM:613695)
- Autosomal dominant inheritance (HP:0000006): A mode of inheritance that is observed for traits related to a gene encoded on one of the autosomes (i.e., the human chromosomes 1-22) in which a trait manifests in heterozygotes. In the context of medical genetics, an autosomal dominant disorder is caused when a single copy of the mutant allele is present. Males and females are affected equally, and can both transmit the disorder with a risk of 50% for each child of inheriting the mutant allele. Evidence: PCS. (PMID:9354802)
- Sudden cardiac death (HP:0001645): The heart suddenly and unexpectedly stops beating resulting in death within a short time period (generally within 1 h of symptom onset). Evidence: TAS. (OMIM:613695)
- Sinus bradycardia (HP:0001688): Bradycardia related to a mean resting sinus rate of less than 50 beats per minute. Evidence: PCS. Frequency: 2/2. (PMID:20823649)